- Autosomal dominant inheritance (HP:0000006): A mode of inheritance that is observed for traits related to a gene encoded on one of the autosomes (i.e., the human chromosomes 1-22) in which a trait manifests in heterozygotes. In the context of medical genetics, an autosomal dominant disorder is caused when a single copy of the mutant allele is present. Males and females are affected equally, and can both transmit the disorder with a risk of 50% for each child of inheriting the mutant allele. Evidence: IEA. (OMIM:137000)
- Abnormality of the skin (HP:0000951): An abnormality of the skin. Evidence: IEA. (OMIM:137000)
These phenotypes are associated with the disease FUTCHER LINE (OMIM:137000).